- Congenital nystagmus (HP:0006934): Nystagmus dating from or present at birth. Evidence: IEA. (OMIM:310700)
- Infantile onset (HP:0003593): Onset of signs or symptoms of disease between 28 days to one year of life. Evidence: IEA. (OMIM:310700)
- Pendular nystagmus (HP:0012043): Rhythmic, involuntary sinusoidal oscillations of one or both eyes. The waveform of pendular nystagmus may occur in any direction. Evidence: TAS. (OMIM:310700)
- Reduced visual acuity (HP:0007663). Evidence: TAS. (OMIM:310700)
- Mildly reduced visual acuity (HP:0032037): Mild reduction of the ability to see. On the 6m visual acuity scale, mild reduction is defined as less than 6/12 but at least 6/18. On the 20ft visual acuity scale, mild reduction is defined as less than 20/40 but at least 20/70. On the decimal visual acuity scale, mild reduction is defined as less than 0.5 but at least 0.3. Evidence: IEA. (OMIM:310700)
- X-linked inheritance (HP:0001417): A mode of inheritance that is observed for traits related to a gene encoded on the X chromosome. Evidence: PCS. (PMID:17013395)
- Horizontal nystagmus (HP:0000666): Nystagmus consisting of horizontal to-and-fro eye movements. Evidence: IEA. (OMIM:310700)
These phenotypes are associated with the disease nystagmus 1, congenital, X-linked (OMIM:310700).